Phenotypes associated with the disease Brain-lung-thyroid syndrome (ORPHA:209905):
- Megacystis (HP:0000021): Dilatation of the bladder postnatally. Evidence: TAS. Frequency: Very rare (HP:0040284). (ORPHA:209905)
- Hypospadias (HP:0000047): Abnormal position of urethral meatus on the ventral penile shaft (underside) characterized by displacement of the urethral meatus from the tip of the glans penis to the ventral surface of the penis, scrotum, or perineum. Evidence: TAS. Frequency: Very rare (HP:0040284). (ORPHA:209905)
- Vesicoureteral reflux (HP:0000076): Abnormal (retrograde) movement of urine from the bladder into ureters or kidneys related to inadequacy of the valvular mechanism at the ureterovesicular junction or other causes. Evidence: TAS. Frequency: Very rare (HP:0040284). (ORPHA:209905)
- Microcephaly (HP:0000252): Head circumference below 2 standard deviations below the mean for age and gender. Evidence: TAS. Frequency: Very rare (HP:0040284). (ORPHA:209905)
- Webbed neck (HP:0000465): Pterygium colli is a congenital skin fold that runs along the sides of the neck down to the shoulders. It involves an ectopic fibrotic facial band superficial to the trapezius muscle. Excess hair-bearing skin is also present and extends down the cervical region well beyond the normal hairline. Evidence: TAS. Frequency: Very rare (HP:0040284). (ORPHA:209905)
- Hypodontia (HP:0000668): The absence of five or less teeth from the normal series by a failure to develop. Evidence: TAS. Frequency: Very rare (HP:0040284). (ORPHA:209905)
- Compulsive behaviors (HP:0000722): Behavior that consists of repetitive acts, characterized by the feeling that one "has to" perform them, while being aware that these acts are not in line with one's overall goal. Evidence: TAS. Frequency: Very rare (HP:0040284). (ORPHA:209905)
- Short attention span (HP:0000736): Reduced attention span characterized by distractibility and impulsivity. Evidence: TAS. Frequency: Very rare (HP:0040284). (ORPHA:209905)
- Hyperactivity (HP:0000752): Hyperactivity is a condition characterized by constant and unusually high levels of activity, even in situations where it is deemed inappropriate. Evidence: TAS. Frequency: Very rare (HP:0040284). (ORPHA:209905)
- Hypoparathyroidism (HP:0000829): A condition caused by a deficiency of parathyroid hormone characterized by hypocalcemia and hyperphosphatemia. Evidence: TAS. Frequency: Very rare (HP:0040284). (ORPHA:209905)
- Agenesis of corpus callosum (HP:0001274): Absence of the corpus callosum as a result of the failure of the corpus callosum to develop, which can be the result of a failure in any one of the multiple steps of callosal development including cellular proliferation and migration, axonal growth or glial patterning at the midline. Evidence: TAS. Frequency: Very rare (HP:0040284). (ORPHA:209905)
- Patent foramen ovale (HP:0001655): Failure of the foramen ovale to seal postnatally, leaving a potential conduit between the left and right cardiac atria. Evidence: TAS. Frequency: Very rare (HP:0040284). (ORPHA:209905)
- Unexplained fevers (HP:0001955): Episodes of fever for which no infectious cause can be identified. Evidence: TAS. Frequency: Very rare (HP:0040284). (ORPHA:209905)
- Abnormal facial shape (HP:0001999): An abnormal morphology (form) of the face or its components. Evidence: TAS. Frequency: Very rare (HP:0040284). (ORPHA:209905)
- Asthma (HP:0002099): Asthma is characterized by increased responsiveness of the tracheobronchial tree to multiple stimuli, leading to narrowing of the air passages with resultant dyspnea, cough, and wheezing. Evidence: TAS. Frequency: Very rare (HP:0040284). (ORPHA:209905)
- Pulmonary fibrosis (HP:0002206): Replacement of normal lung tissues by fibroblasts and collagen. Evidence: TAS. Frequency: Very rare (HP:0040284). (ORPHA:209905)
- Sleep disturbance (HP:0002360): An abnormal pattern in the quality, quantity, or characteristics of sleep. Evidence: TAS. Frequency: Very rare (HP:0040284). (ORPHA:209905)
- Cavum septum pellucidum (HP:0002389): If the two laminae of the septum pellucidum are not fused then a fluid-filled space or cavum is present. The cavum septum pellucidum is present at birth but usually obliterates by the age of 3 to 6 months. It is up to 1cm in width and the walls are parallel. It is an enclosed space and is not part of the ventricular system or connected with the subarachnoid space. Evidence: TAS. Frequency: Very rare (HP:0040284). (ORPHA:209905)
- Falls (HP:0002527). Evidence: TAS. Frequency: Very rare (HP:0040284). (ORPHA:209905)
- Abnormal sella turcica morphology (HP:0002679): Abnormality of the sella turcica, a saddle-shaped depression in the sphenoid bone at the base of the human skull. Evidence: TAS. Frequency: Very rare (HP:0040284). (ORPHA:209905)
- Respiratory failure (HP:0002878): A severe form of respiratory insufficiency characterized by inadequate gas exchange such that the levels of oxygen or carbon dioxide cannot be maintained within normal limits. Evidence: TAS. Frequency: Very rare (HP:0040284). (ORPHA:209905)
- Short stature (HP:0004322): A height below that which is expected according to age and gender norms. Although there is no universally accepted definition of short stature, many refer to "short stature" as height more than 2 standard deviations below the mean for age and gender (or below the 3rd percentile for age and gender dependent norms). Evidence: TAS. Frequency: Very rare (HP:0040284). (ORPHA:209905)
- Abnormal drinking behavior (HP:0030082): Abnormal consumption of fluids with excessive or insufficient consumption of fluid or any other abnormal pattern of fluid consumption. Evidence: TAS. Frequency: Very rare (HP:0040284). (ORPHA:209905)
- Abnormal eating behavior (HP:0100738): Abnormal eating habits involve excessive or insufficient consumption of food, or any other abnormal pattern of food consumption. Evidence: TAS. Frequency: Very rare (HP:0040284). (ORPHA:209905)
- Schizophrenia (HP:0100753): A mental disorder characterized by a disintegration of thought processes and emotional responsiveness. It most commonly manifests as auditory hallucinations, paranoid or bizarre delusions, or disorganized speech and thinking. It is accompanied by significant social or occupational dysfunction. The onset of symptoms typically occurs in young adulthood, with a global lifetime prevalence of about 1%. This term is not a helpful parent term to describe abnormal experiences. Evidence: TAS. Frequency: Very rare (HP:0040284). (ORPHA:209905)
- Abnormality of the thyroid gland (HP:0000820): An abnormality of the thyroid gland. Evidence: TAS. Frequency: Very frequent (HP:0040281). (ORPHA:209905)
- Abnormality of the nervous system (HP:0000707): An abnormality of the nervous system. Evidence: TAS. Frequency: Frequent (HP:0040282). (ORPHA:209905)
- Congenital hypothyroidism (HP:0000851): A type of hypothyroidism with congenital onset. Evidence: TAS. Frequency: Frequent (HP:0040282). (ORPHA:209905)
- Ataxia (HP:0001251): Ataxia refers to impaired coordination of voluntary muscle movement. Cerebellar ataxia refers to ataxia due to dysfunction of the cerebellum. This causes a variety of elementary neurological deficits including asynergy (lack of coordination between muscles, limbs and joints), dysmetria (lack of ability to judge distances that can lead to under- or overshoot in grasping movements), and dysdiadochokinesia (inability to perform rapid movements requiring antagonizing muscle groups to be switched on and off repeatedly). Evidence: TAS. Frequency: Frequent (HP:0040282). (ORPHA:209905)
- Choreoathetosis (HP:0001266): Involuntary movements characterized by both athetosis (inability to sustain muscles in a fixed position) and chorea (widespread jerky arrhythmic movements). Evidence: TAS. Frequency: Frequent (HP:0040282). (ORPHA:209905)
- Chorea (HP:0002072): Chorea (Greek for 'dance') refers to widespread arrhythmic involuntary movements of a forcible, jerky and restless fashion. It is a random-appearing sequence of one or more discrete involuntary movements or movement fragments. Movements appear random because of variability in timing, duration or location. Each movement may have a distinct start and end. However, movements may be strung together and thus may appear to flow randomly from one muscle group to another. Chorea can involve the trunk, neck, face, tongue, and extremities. Evidence: TAS. Frequency: Frequent (HP:0040282). (ORPHA:209905)
- Abnormality of the respiratory system (HP:0002086): An abnormality of the respiratory system, which include the airways, lungs, and the respiratory muscles. Evidence: TAS. Frequency: Frequent (HP:0040282). (ORPHA:209905)
- Respiratory distress (HP:0002098): Respiratory distress is objectively observable as the physical or emotional consequences from the experience of dyspnea. The physical presentation of respiratory distress is generally referred to as labored breathing, while the sensation of respiratory distress is called shortness of breath or dyspnea. Evidence: TAS. Frequency: Frequent (HP:0040282). (ORPHA:209905)
- Neonatal respiratory distress (HP:0002643): Respiratory difficulty as newborn. Evidence: TAS. Frequency: Frequent (HP:0040282). (ORPHA:209905)
- Floppy infant (HP:0008947): Floppiness/hypotonia is defined as reduced resistance to passive movement of joints. Physical examination of floppy/hypotonic infants shows head lag, lack of shoulder and elbow muscle contraction on traction response, inability to tighten the shoulder girdle muscles (or slipping through) when held under the axillae, scarf sign (when the arm is pulled to the opposite side, the arm wraps around the neck with the elbow crossing midline), hyperdorsiflexion of the feet, easy apposition of the thumb against the forearm, feet touching the cheek with ease and without discomfort, frog leg position, and inverted U sign on ventral suspension (head, arms, and legs hanging down without elbow or knee flexion and the trunk rounded in a dome shape). Evidence: TAS. Frequency: Frequent (HP:0040282). (ORPHA:209905)
- Sensorineural hearing impairment (HP:0000407): A type of hearing impairment in one or both ears related to an abnormal functionality of the cochlear nerve. Evidence: TAS. Frequency: Occasional (HP:0040283). (ORPHA:209905)
- Mild intellectual disability (HP:0001256): Mild intellectual disability (ID) is defined as a type of ID characterized by mildly sub-average adaptive functioning and intellectual functioning, with an intelligence quotient (IQ) the range of 50-69. Evidence: TAS. Frequency: Occasional (HP:0040283). (ORPHA:209905)
- Dysarthria (HP:0001260): Dysarthric speech is a general description referring to a neurological speech disorder characterized by poor articulation. Depending on the involved neurological structures, dysarthria may be further classified as spastic, flaccid, ataxic, hyperkinetic and hypokinetic, or mixed. Evidence: TAS. Frequency: Occasional (HP:0040283). (ORPHA:209905)
- Global developmental delay (HP:0001263): A delay in the achievement of motor or mental milestones in the domains of development of a child, including motor skills, speech and language, cognitive skills, and social and emotional skills. This term should only be used to describe children younger than five years of age. Evidence: TAS. Frequency: Occasional (HP:0040283). (ORPHA:209905)
- Motor delay (HP:0001270): A type of Developmental delay characterized by a delay in acquiring motor skills. Evidence: TAS. Frequency: Occasional (HP:0040283). (ORPHA:209905)
- Dystonia (HP:0001332): An abnormally increased muscular tone that causes fixed abnormal postures. There is a slow, intermittent twisting motion that leads to exaggerated turning and posture of the extremities and trunk. Evidence: TAS. Frequency: Occasional (HP:0040283). (ORPHA:209905)
- Myoclonus (HP:0001336): Very brief, involuntary random muscular contractions occurring at rest, in response to sensory stimuli, or accompanying voluntary movements. Evidence: TAS. Frequency: Occasional (HP:0040283). (ORPHA:209905)
- Failure to thrive (HP:0001508): Failure to thrive (FTT) refers to a child whose physical growth is substantially below the norm. Evidence: TAS. Frequency: Occasional (HP:0040283). (ORPHA:209905)
- Growth delay (HP:0001510): A deficiency or slowing down of growth pre- and postnatally. Evidence: TAS. Frequency: Occasional (HP:0040283). (ORPHA:209905)
- Ventricular septal defect (HP:0001629): A hole between the two bottom chambers (ventricles) of the heart. The defect is centered around the most superior aspect of the ventricular septum. Evidence: TAS. Frequency: Occasional (HP:0040283). (ORPHA:209905)
- Atrial septal defect (HP:0001631): Atrial septal defect (ASD) is a congenital abnormality of the interatrial septum that enables blood flow between the left and right atria via the interatrial septum. Evidence: TAS. Frequency: Occasional (HP:0040283). (ORPHA:209905)
- Abnormal cardiac septum morphology (HP:0001671): An anomaly of the intra-atrial or intraventricular septum. Evidence: TAS. Frequency: Occasional (HP:0040283). (ORPHA:209905)
- Intention tremor (HP:0002080): A type of kinetic tremor that occurs during target directed movement is called intention tremor. That is, an oscillatory cerebellar ataxia that tends to be absent when the limbs are inactive and during the first part of voluntary movement but worsening as the movement continues and greater precision is required (e.g., in touching a target such as the patient's nose or a physician's finger). Evidence: TAS. Frequency: Occasional (HP:0040283). (ORPHA:209905)
- Pulmonary arterial hypertension (HP:0002092): Pulmonary hypertension is defined mean pulmonary artery pressure of 25mmHg or more and pulmonary capillary wedge pressure of 15mmHg or less when measured by right heart catheterisation at rest and in a supine position. Evidence: TAS. Frequency: Occasional (HP:0040283). (ORPHA:209905)
- Apraxia (HP:0002186): A defect in the understanding of complex motor commands and in the execution of certain learned movements, i.e., deficits in the cognitive components of learned movements. Evidence: TAS. Frequency: Occasional (HP:0040283). (ORPHA:209905)
- Recurrent respiratory infections (HP:0002205): An increased susceptibility to respiratory infections as manifested by a history of recurrent respiratory infections. Evidence: TAS. Frequency: Occasional (HP:0040283). (ORPHA:209905)
- Incoordination (HP:0002311): A deficit in coordination of muscle movements. Coordination is defined as the orchestrated movement of multiple body parts as required to accomplish intended actions, like walking. Evidence: TAS. Frequency: Occasional (HP:0040283). (ORPHA:209905)
- Clumsiness (HP:0002312): Lack of physical coordination resulting in an abnormal tendency to drop items or bump into objects. Evidence: TAS. Frequency: Occasional (HP:0040283). (ORPHA:209905)
- Elevated circulating thyroid-stimulating hormone concentration (HP:0002925): Increased concentration of thyroid-stimulating hormone (TSH) in the blood circulation. Evidence: TAS. Frequency: Occasional (HP:0040283). (ORPHA:209905)
- Involuntary movements (HP:0004305): Involuntary contractions of muscle leading to involuntary movements of extremities, neck, trunk, or face. Evidence: TAS. Frequency: Occasional (HP:0040283). (ORPHA:209905)
- Abnormal pulmonary interstitial morphology (HP:0006530): Abnormality of the lung parenchyma extending to the pulmonary interstitium and leading to diffuse pulmonary fibrosis. Evidence: TAS. Frequency: Occasional (HP:0040283). (ORPHA:209905)
- Recurrent pneumonia (HP:0006532): An increased susceptibility to pneumonia as manifested by a history of recurrent episodes of pneumonia. Evidence: TAS. Frequency: Occasional (HP:0040283). (ORPHA:209905)
- Thyroid dysgenesis (HP:0008188): Thyroid dysgenesis is a descriptive term that should be avoided if more precise information is available. However, the HPO keeps retains this term because it is commonly used in the medical literature. In humans, the process of thyroid morphogenesis occurs from the 3rd to 16th week of gestation. Alterations occurring during this period may result in a thyroid gland that is absent (thyroid agenesis or athyreosis), hypoplastic (thyroid hypoplasia), or located in an unusual position (thyroid ectopy). All these entities are grouped under the term thyroid dysgenesis. Evidence: TAS. Frequency: Occasional (HP:0040283). (ORPHA:209905)
- Compensated hypothyroidism (HP:0008223): Condition associated with a raised serum concentration of thyroid stimulating hormone (TSH) but a normal serum free thyroxine (FT4). Evidence: TAS. Frequency: Occasional (HP:0040283). (ORPHA:209905)
- Thyroid hemiagenesis (HP:0011780): Absence of a lobe of the thyroid gland related to a failure of its embryologic development. Evidence: TAS. Frequency: Occasional (HP:0040283). (ORPHA:209905)